Phenotypes associated with the disease Laryngeal abductor paralysis (ORPHA:2808, an Orphanet rare-disease identifier):
- Laryngomalacia (HP:0001601, a Human Phenotype Ontology term): Laryngomalacia is a congenital abnormality of the laryngeal cartilage in which the cartilage is floppy and prolapses over the larynx during inspiration. Evidence: TAS. Frequency: Very frequent (HP:0040281, a Human Phenotype Ontology term). (ORPHA:2808)
- Respiratory insufficiency (HP:0002093, a Human Phenotype Ontology term). Evidence: TAS. Frequency: Frequent (HP:0040282, a Human Phenotype Ontology term). (ORPHA:2808)